Phenotypes associated with the disease Oguchi disease (ORPHA:75382):
- Early-onset non-progressive night blindness (HP:0007642): A usually nonprogressive (i.e., stationary) form of night blindness with early (presumed to be congenital) onset. Evidence: TAS. Frequency: Very frequent (HP:0040281). (ORPHA:75382)
- ERG: Reduced dark-adapted b-wave amplitude (HP:0007984): A dark-adapted bright flash electroretinogram in which the b-wave that is of markedly lower amplitude than the associated a-wave. Evidence: TAS. Frequency: Very frequent (HP:0040281). (ORPHA:75382)
- Mizuo phenomenon (HP:0030824): Change in the color of the fundus from red in the dark-adapted state to golden immediately or shortly after the onset of the light. The color of the fundus reflex in the light adapted state has also been described as golden-yellow, gray-white, and yellow-white. This reflex can appear either homogeneous or in streaks in the fundus. The retinal vessels appear to be protruding in contrast to the radiant background. Dark adaptation leads to disappearance of the unusual fundus coloration [Digital Journal of Ophthalmology 2008; Volume 14, Number 14]. Evidence: TAS. Frequency: Very frequent (HP:0040281). (ORPHA:75382)
- Abnormality of refraction (HP:0000539): An abnormality in the process of focusing of light by the eye in order to produce a sharp image on the retina. Evidence: TAS. Frequency: Occasional (HP:0040283). (ORPHA:75382)
- Myopia (HP:0000545): An abnormality of refraction characterized by the ability to see objects nearby clearly, while objects in the distance appear blurry. Evidence: TAS. Frequency: Occasional (HP:0040283). (ORPHA:75382)
- Macular degeneration (HP:0000608): A nonspecific term denoting degeneration of the retinal pigment epithelium and/or retinal photoreceptor cells of the macula lutea. Evidence: TAS. Frequency: Occasional (HP:0040283). (ORPHA:75382)
- Strabismus (HP:0000486): A misalignment of the eyes so that the visual axes deviate from bifoveal fixation. The classification of strabismus may be based on a number of features including the relative position of the eyes, whether the deviation is latent or manifest, intermittent or constant, concomitant or otherwise and according to the age of onset and the relevance of any associated refractive error. Evidence: TAS. Frequency: Very rare (HP:0040284). (ORPHA:75382)
- Visual impairment (HP:0000505): Visual impairment (or vision impairment) is vision loss (of a person) to such a degree as to qualify as an additional support need through a significant limitation of visual capability resulting from either disease, trauma, or congenital or degenerative conditions that cannot be corrected by conventional means, such as refractive correction, medication, or surgery. Evidence: TAS. Frequency: Very rare (HP:0040284). (ORPHA:75382)
- Rod-cone dystrophy (HP:0000510): An inherited retinal disease subtype in which the rod photoreceptors appear to be more severely affected than the cone photoreceptors. Typical presentation is with nyctalopia (due to rod dysfunction) followed by loss of mid-peripheral field of vision, which gradually extends and leaves many patients with a small central island of vision due to the preservation of macular cones. Evidence: TAS. Frequency: Very rare (HP:0040284). (ORPHA:75382)
- Nystagmus (HP:0000639): Rhythmic, involuntary oscillations of one or both eyes related to abnormality in fixation, conjugate gaze, or vestibular mechanisms. Evidence: TAS. Frequency: Very rare (HP:0040284). (ORPHA:75382)
- Diplopia (HP:0000651): Diplopia is a condition in which a single object is perceived as two images, it is also known as double vision. Evidence: TAS. Frequency: Very rare (HP:0040284). (ORPHA:75382)
Not associated with this disease:
- Visual field defect (HP:0001123). Evidence: TAS. (ORPHA:75382)
- Dyschromatopsia (HP:0007641): A form of colorblindness in which only two of the three fundamental colors can be distinguished due to a lack of one of the retinal cone pigments. Evidence: TAS. (ORPHA:75382)